Phenotypes associated with the disease intellectual disability, X-linked 1 (OMIM:309530):
- Poor speech (HP:0002465). Evidence: TAS. (OMIM:309530)
- Bilateral tonic-clonic seizure (HP:0002069): A bilateral tonic-clonic seizure is a seizure defined by a tonic (bilateral increased tone, lasting seconds to minutes) and then a clonic (bilateral sustained rhythmic jerking) phase. Evidence: PCS. Frequency: 1/1. (PMID:29026562)
- Strabismus (HP:0000486): A misalignment of the eyes so that the visual axes deviate from bifoveal fixation. The classification of strabismus may be based on a number of features including the relative position of the eyes, whether the deviation is latent or manifest, intermittent or constant, concomitant or otherwise and according to the age of onset and the relevance of any associated refractive error. Evidence: TAS. (OMIM:309530)
- Delayed speech and language development (HP:0000750): A degree of language development that is significantly below the norm for a child of a specified age. Evidence: PCS. Frequency: 1/1. (PMID:29026562)
- Hypermetropia (HP:0000540): An abnormality of refraction characterized by the ability to see objects in the distance clearly, while objects nearby appear blurry. Evidence: TAS. (OMIM:309530)
- Developmental regression (HP:0002376): Loss of developmental skills, as manifested by loss of developmental milestones. Evidence: PCS. Frequency: 1/1. (PMID:29026562)
- Seizure (HP:0001250): A seizure is an intermittent abnormality of nervous system physiology characterized by a transient occurrence of signs and/or symptoms due to abnormal excessive or synchronous neuronal activity in the brain. Evidence: PCS. Frequency: 3/13. (PMID:29026562;PMID:26793055)
- Atonic seizure (HP:0010819): Atonic seizure is a type of motor seizure characterized by a sudden loss or diminution of muscle tone without apparent preceding myoclonic or tonic event lasting about 1 to 2 seconds, involving head, trunk, jaw, or limb musculature. Evidence: PCS. Frequency: 1/1. (PMID:29026562)
- Secondary microcephaly (HP:0005484): Head circumference which falls below 2 standard deviations below the mean for age and gender because of insufficient head growth after birth. Evidence: TAS. Frequency: Occasional (HP:0040283). (OMIM:309530)
- Infantile onset (HP:0003593): Onset of signs or symptoms of disease between 28 days to one year of life. Evidence: PCS. Frequency: 1/1. (PMID:29026562)
- Generalized hypotonia (HP:0001290): Generalized muscular hypotonia (abnormally low muscle tone). Evidence: TAS. (OMIM:309530)
- X-linked recessive inheritance (HP:0001419): A mode of inheritance that is observed for recessive traits related to a gene encoded on the X chromosome. In the context of medical genetics, X-linked recessive disorders manifest in males (who have one copy of the X chromosome and are thus hemizygotes), but generally not in female heterozygotes who have one mutant and one normal allele. Evidence: IEA. (OMIM:309530)
- Aggressive behavior (HP:0000718): Behavior or an act aimed at harming a person, animal, or physical property (e.g., acts of physical violence; shouting, swearing, and using harsh language; slashing someone's tires). Evidence: PCS. Frequency: 3/12. (PMID:26793055)
- Autistic behavior (HP:0000729): Persistent deficits in social interaction and communication and interaction as well as a markedly restricted repertoire of activity and interest as well as repetitive patterns of behavior. Evidence: PCS. Frequency: 3/13. (PMID:29026562;PMID:26793055)
- No social interaction (HP:0008763): Lack of intentional participation in interactions with another person. Evidence: PCS. Frequency: 1/1. (PMID:29026562)
- X-linked dominant inheritance (HP:0001423): A mode of inheritance that is observed for dominant traits related to a gene encoded on the X chromosome. In the context of medical genetics, X-linked dominant disorders tend to manifest very severely in affected males. The severity of manifestation in females may depend on the degree of skewed X inactivation. Evidence: PCS. (PMID:26793055)
- Intellectual disability (HP:0001249): The term intellectual disability or intellectual developmental disorder is used to describe significantly sub-average intellectual and adaptive functioning based on clinical assessment and as measured by individually administered, appropriately normed, standardized and validated tests of intellectual functioning and adaptive behavior, with onset during the developmental period from infancy through adolescence. Evidence: PCS. Frequency: 5/6. (PMID:26793055)
- Intellectual disability (HP:0001249): The term intellectual disability or intellectual developmental disorder is used to describe significantly sub-average intellectual and adaptive functioning based on clinical assessment and as measured by individually administered, appropriately normed, standardized and validated tests of intellectual functioning and adaptive behavior, with onset during the developmental period from infancy through adolescence. Evidence: PCS. Frequency: 4/6. (PMID:26793055)
- Intellectual disability (HP:0001249): The term intellectual disability or intellectual developmental disorder is used to describe significantly sub-average intellectual and adaptive functioning based on clinical assessment and as measured by individually administered, appropriately normed, standardized and validated tests of intellectual functioning and adaptive behavior, with onset during the developmental period from infancy through adolescence. Evidence: PCS. Frequency: 1/1. (PMID:29026562)
- Brachycephaly (HP:0000248): An abnormality of skull shape characterized by a decreased anterior-posterior diameter. That is, a cephalic index greater than 81%. Alternatively, an apparently shortened anteroposterior dimension (length) of the head compared to width. Evidence: TAS. (OMIM:309530)